Phenotypes associated with the disease torsion dystonia 13 (OMIM:607671):
- Torticollis (HP:0000473): Involuntary contractions of the neck musculature resulting in an abnormal posture of or abnormal movements of the head. Evidence: IEA. (OMIM:607671)
- Writer's cramp (HP:0002356): A focal dystonia of the fingers, hand, and/or forearm that appears when the affected person attempts to do a task that requires fine motor movements such as writing or playing a musical instrument. Evidence: IEA. (OMIM:607671)
- Limb dystonia (HP:0002451): A type of dystonia (abnormally increased muscular tone causing fixed abnormal postures) that affects muscles of the limbs. Evidence: IEA. (OMIM:607671)
- Oromandibular dystonia (HP:0012048): A kind of focal dystonia characterized by forceful contractions of the face, jaw, and/or tongue causing difficulty in opening and closing the mouth and often affecting chewing and speech. Evidence: IEA. (OMIM:607671)
- Autosomal dominant inheritance (HP:0000006): A mode of inheritance that is observed for traits related to a gene encoded on one of the autosomes (i.e., the human chromosomes 1-22) in which a trait manifests in heterozygotes. In the context of medical genetics, an autosomal dominant disorder is caused when a single copy of the mutant allele is present. Males and females are affected equally, and can both transmit the disorder with a risk of 50% for each child of inheriting the mutant allele. Evidence: IEA. (OMIM:607671)
- Torsion dystonia (HP:0001304): Sustained involuntary muscle contractions that produce twisting and repetitive movements of the body. Evidence: IEA. (OMIM:607671)
- Tremor (HP:0001337): An unintentional, oscillating to-and-fro muscle movement about a joint axis. Evidence: IEA. (OMIM:607671)
- Blepharospasm (HP:0000643): A focal dystonia that affects the muscles of the eyelids and brow, associated with involuntary recurrent spasm of both eyelids. Evidence: IEA. (OMIM:607671)